- Choroid plexus carcinoma (HP:0030392): Intraventricular papillary neoplasm derived from choroid plexus epithelium. Plexus tumors are most common in the lateral and fourth ventricles; while 80% of lateral ventricle tumors present in children, fourth ventricle tumors are evenly distributed in all age groups. Clinically, choroid plexus tumors tend to cause hydrocephalus and increased intracranial pressure. Histologically, choroid plexus papillomas correspond to WHO grade I, choroid plexus carcinomas to WHO grade III. Evidence: PCS. Frequency: 1/1. Onset: Infantile onset (HP:0003593). (PMID:18762572)
- Adrenocortical carcinoma (HP:0006744): A malignant neoplasm of the adrenal cortex that may produce hormones such as cortisol, aldosterone, estrogen, or testosterone. Evidence: PCS. Frequency: 1/1. Onset: Infantile onset (HP:0003593). (PMID:18762572)
- Autosomal dominant inheritance (HP:0000006): A mode of inheritance that is observed for traits related to a gene encoded on one of the autosomes (i.e., the human chromosomes 1-22) in which a trait manifests in heterozygotes. In the context of medical genetics, an autosomal dominant disorder is caused when a single copy of the mutant allele is present. Males and females are affected equally, and can both transmit the disorder with a risk of 50% for each child of inheriting the mutant allele. Evidence: PCS. (PMID:18762572)
These phenotypes are associated with the disease adrenocortical carcinoma, hereditary (OMIM:202300).